- Peters anomaly (HP:0000659): A form of anterior segment dysgenesis in which abnormal cleavage of the anterior chamber occurs. Peters anomaly is characterized by central, paracentral, or complete corneal opacity. Evidence: TAS. Frequency: Obligate (HP:0040280). (ORPHA:708)
- Subcapsular cataract (HP:0000523): A cataract that affects the region of the lens directly beneath the capsule of the lens. Evidence: TAS. Frequency: Very frequent (HP:0040281). (ORPHA:708)
- Opacification of the corneal stroma (HP:0007759): Reduced transparency of the stroma of cornea. Evidence: TAS. Frequency: Very frequent (HP:0040281). (ORPHA:708)
- Anterior synechiae of the anterior chamber (HP:0011483): Adhesions between the iris and the cornea. Evidence: TAS. Frequency: Very frequent (HP:0040281). (ORPHA:708)
- Central opacification of the cornea (HP:0011493): Reduced transparency of the central portion of the corneal stroma. Evidence: TAS. Frequency: Very frequent (HP:0040281). (ORPHA:708)
- Thinning of Descemet membrane (HP:0031159): A reduction in the thickness of Descemet's membrane. Evidence: TAS. Frequency: Very frequent (HP:0040281). (ORPHA:708)
- Developmental glaucoma (HP:0001087): Glaucoma which forms during the early years of a child's life is called developmental or congenital glaucoma. Evidence: TAS. Frequency: Frequent (HP:0040282). (ORPHA:708)
- Strabismus (HP:0000486): A misalignment of the eyes so that the visual axes deviate from bifoveal fixation. The classification of strabismus may be based on a number of features including the relative position of the eyes, whether the deviation is latent or manifest, intermittent or constant, concomitant or otherwise and according to the age of onset and the relevance of any associated refractive error. Evidence: TAS. Frequency: Very rare (HP:0040284). (ORPHA:708)
- Nystagmus (HP:0000639): Rhythmic, involuntary oscillations of one or both eyes related to abnormality in fixation, conjugate gaze, or vestibular mechanisms. Evidence: TAS. Frequency: Very rare (HP:0040284). (ORPHA:708)
These phenotypes are associated with the disease Peters anomaly (ORPHA:708).